Phenotypes associated with the disease ear folding (OMIM:128500):
- Abnormality of the ear (HP:0000598): An abnormality of the ear. Evidence: IEA. (OMIM:128500)
- Autosomal dominant inheritance (HP:0000006): A mode of inheritance that is observed for traits related to a gene encoded on one of the autosomes (i.e., the human chromosomes 1-22) in which a trait manifests in heterozygotes. In the context of medical genetics, an autosomal dominant disorder is caused when a single copy of the mutant allele is present. Males and females are affected equally, and can both transmit the disorder with a risk of 50% for each child of inheriting the mutant allele. Evidence: IEA. (OMIM:128500)